Phenotypes associated with the disease Intellectual disability-short stature-hypertelorism syndrome (ORPHA:3074):
- Hypertelorism (HP:0000316): Interpupillary distance more than 2 SD above the mean (alternatively, the appearance of an increased interpupillary distance or widely spaced eyes). Evidence: TAS. Frequency: Very frequent (HP:0040281). (ORPHA:3074)
- Broad forehead (HP:0000337): Width of the forehead or distance between the frontotemporales is more than two standard deviations above the mean (objective); or apparently increased distance between the two sides of the forehead. Evidence: TAS. Frequency: Very frequent (HP:0040281). (ORPHA:3074)
- Long philtrum (HP:0000343): Distance between nasal base and midline upper lip vermilion border more than 2 SD above the mean. Alternatively, an apparently increased distance between nasal base and midline upper lip vermilion border. Evidence: TAS. Frequency: Frequent (HP:0040282). (ORPHA:3074)
- Wide nose (HP:0000445): Interalar distance more than two standard deviations above the mean for age, i.e., an apparently increased width of the nasal base and alae. Evidence: TAS. Frequency: Frequent (HP:0040282). (ORPHA:3074)
- Anteverted nares (HP:0000463): Anteriorly-facing nostrils viewed with the head in the Frankfurt horizontal and the eyes of the observer level with the eyes of the subject. This gives the appearance of an upturned nose (upturned nasal tip). Evidence: TAS. Frequency: Very frequent (HP:0040281). (ORPHA:3074)
- Intellectual disability (HP:0001249): The term intellectual disability or intellectual developmental disorder is used to describe significantly sub-average intellectual and adaptive functioning based on clinical assessment and as measured by individually administered, appropriately normed, standardized and validated tests of intellectual functioning and adaptive behavior, with onset during the developmental period from infancy through adolescence. Evidence: TAS. Frequency: Frequent (HP:0040282). (ORPHA:3074)
- Frontal bossing (HP:0002007): Bilateral bulging of the lateral frontal bone prominences with relative sparing of the midline. Evidence: TAS. Frequency: Very frequent (HP:0040281). (ORPHA:3074)
- Clinodactyly of the 5th finger (HP:0004209): Clinodactyly refers to a bending or curvature of the fifth finger in the radial direction (i.e., towards the 4th finger). Evidence: TAS. Frequency: Frequent (HP:0040282). (ORPHA:3074)
- Hypoplasia of the zygomatic bone (HP:0010669): Underdevelopment of the zygomatic bone. That is, a reduction in size of the zygomatic bone, including the zygomatic process of the temporal bone of the skull, which forms part of the zygomatic arch. Evidence: TAS. Frequency: Very frequent (HP:0040281). (ORPHA:3074)